- Multiple exostoses (HP:0002762): Presence of more than one exostosis. An exostosis is a benign growth the projects outward from the bone surface. It is capped by cartilage, and arises from a bone that develops from cartilage. Evidence: IEA. (OMIM:158345)
- Spastic tetraparesis (HP:0001285): Spastic weakness affecting all four limbs. Evidence: IEA. (OMIM:158345)
- Autosomal dominant inheritance (HP:0000006): A mode of inheritance that is observed for traits related to a gene encoded on one of the autosomes (i.e., the human chromosomes 1-22) in which a trait manifests in heterozygotes. In the context of medical genetics, an autosomal dominant disorder is caused when a single copy of the mutant allele is present. Males and females are affected equally, and can both transmit the disorder with a risk of 50% for each child of inheriting the mutant allele. Evidence: IEA. (OMIM:158345)
These phenotypes are associated with the disease multiple exostoses with spastic tetraparesis (OMIM:158345).